- Cleft palate (HP:0000175): Cleft palate is a developmental defect of the palate resulting from a failure of fusion of the palatine processes and manifesting as a separation of the roof of the mouth (soft and hard palate). Evidence: TAS. Frequency: Very frequent (HP:0040281). (ORPHA:2117)
- Hypertelorism (HP:0000316): Interpupillary distance more than 2 SD above the mean (alternatively, the appearance of an increased interpupillary distance or widely spaced eyes). Evidence: TAS. Frequency: Very frequent (HP:0040281). (ORPHA:2117)
- Downslanted palpebral fissures (HP:0000494): The palpebral fissure inclination is more than two standard deviations below the mean. Evidence: TAS. Frequency: Very frequent (HP:0040281). (ORPHA:2117)
- Telecanthus (HP:0000506): Distance between the inner canthi more than two standard deviations above the mean (objective); or, apparently increased distance between the inner canthi. Evidence: TAS. Frequency: Very frequent (HP:0040281). (ORPHA:2117)
- Ptosis (HP:0000508): The upper eyelid margin is positioned 3 mm or more lower than usual and covers the superior portion of the iris (objective); or, the upper lid margin obscures at least part of the pupil (subjective). Evidence: TAS. Frequency: Very frequent (HP:0040281). (ORPHA:2117)
- Microphthalmia (HP:0000568): A developmental anomaly characterized by abnormal smallness of one or both eyes. Evidence: TAS. Frequency: Very frequent (HP:0040281). (ORPHA:2117)
- Craniosynostosis (HP:0001363): Craniosynostosis refers to the premature closure of the cranial sutures. Primary craniosynostosis refers to the closure of one or more sutures due to abnormalities in skull development, and secondary craniosynostosis results from failure of brain growth. Evidence: TAS. Frequency: Very frequent (HP:0040281). (ORPHA:2117)
- Intrauterine growth retardation (HP:0001511): An abnormal restriction of fetal growth with fetal weight below the tenth percentile for gestational age. Evidence: TAS. Frequency: Very frequent (HP:0040281). (ORPHA:2117)
- Encephalocele (HP:0002084): A neural tube defect characterized by sac-like protrusions of the brain and the membranes that cover it through openings in the skull. Evidence: TAS. Frequency: Very frequent (HP:0040281). (ORPHA:2117)
- Respiratory insufficiency (HP:0002093). Evidence: TAS. Frequency: Very frequent (HP:0040281). (ORPHA:2117)
- Depressed nasal bridge (HP:0005280): Posterior positioning of the nasal root in relation to the overall facial profile for age. Evidence: TAS. Frequency: Very frequent (HP:0040281). (ORPHA:2117)
- Lobar holoprosencephaly (HP:0006870): A type of holoprosencephaly in which most of the right and left cerebral hemispheres and lateral ventricles are separated but the most rostral aspect of the telencephalon, the frontal lobes, are fused, especially ventrally. Evidence: TAS. Frequency: Very frequent (HP:0040281). (ORPHA:2117)
- Aplasia/Hypoplasia of the corpus callosum (HP:0007370): Absence or underdevelopment of the corpus callosum. Evidence: TAS. Frequency: Very frequent (HP:0040281). (ORPHA:2117)
- Non-midline cleft of the upper lip (HP:0100335): Clefting (gap or groove) of the upper lip affecting the lateral portions of the upper lip rather than the midline/median region. Evidence: TAS. Frequency: Very frequent (HP:0040281). (ORPHA:2117)
- Split hand (HP:0001171): A condition in which middle parts of the hand (fingers and metacarpals) are missing giving a cleft appearance. The severity is very variable ranging from slightly hypoplastic middle fingers over absent middle fingers as far as oligo- or monodactyl hands. Evidence: TAS. Frequency: Frequent (HP:0040282). (ORPHA:2117)
- Aplasia/Hypoplasia of the radius (HP:0006501): A small/hypoplastic or absent/aplastic radius. Evidence: TAS. Frequency: Frequent (HP:0040282). (ORPHA:2117)
- Posteriorly rotated ears (HP:0000358): A type of abnormal location of the ears in which the position of the ears is characterized by posterior rotation (the superior part of the ears is rotated towards the back of the head, and the inferior part of the ears towards the front). Evidence: TAS. Frequency: Very frequent (HP:0040281). (ORPHA:2117)
These phenotypes are associated with the disease Hartsfield syndrome (ORPHA:2117).